Phenotypes associated with the disease Craniosynostosis-Dandy-Walker malformation-hydrocephalus syndrome (ORPHA:1538):
- Hydrocephalus (HP:0000238): Hydrocephalus is an active distension of the ventricular system of the brain resulting from inadequate passage of CSF from its point of production within the cerebral ventricles to its point of absorption into the systemic circulation. Evidence: TAS. Frequency: Very frequent (HP:0040281). (ORPHA:1538)
- Dolichocephaly (HP:0000268): An abnormality of skull shape characterized by a increased anterior-posterior diameter, i.e., an increased antero-posterior dimension of the skull. Cephalic index less than 76%. Alternatively, an apparently increased antero-posterior length of the head compared to width. Often due to premature closure of the sagittal suture. Evidence: TAS. Frequency: Very frequent (HP:0040281). (ORPHA:1538)
- Hypertelorism (HP:0000316): Interpupillary distance more than 2 SD above the mean (alternatively, the appearance of an increased interpupillary distance or widely spaced eyes). Evidence: TAS. Frequency: Very frequent (HP:0040281). (ORPHA:1538)
- Micrognathia (HP:0000347): Developmental hypoplasia of the mandible. Evidence: TAS. Frequency: Very frequent (HP:0040281). (ORPHA:1538)
- Strabismus (HP:0000486): A misalignment of the eyes so that the visual axes deviate from bifoveal fixation. The classification of strabismus may be based on a number of features including the relative position of the eyes, whether the deviation is latent or manifest, intermittent or constant, concomitant or otherwise and according to the age of onset and the relevance of any associated refractive error. Evidence: TAS. Frequency: Frequent (HP:0040282). (ORPHA:1538)
- Optic atrophy (HP:0000648): Atrophy of the optic nerve. Optic atrophy results from the death of the retinal ganglion cell axons that comprise the optic nerve and manifesting as a pale optic nerve on fundoscopy. Evidence: TAS. Frequency: Very frequent (HP:0040281). (ORPHA:1538)
- Intellectual disability (HP:0001249): The term intellectual disability or intellectual developmental disorder is used to describe significantly sub-average intellectual and adaptive functioning based on clinical assessment and as measured by individually administered, appropriately normed, standardized and validated tests of intellectual functioning and adaptive behavior, with onset during the developmental period from infancy through adolescence. Evidence: TAS. Frequency: Frequent (HP:0040282). (ORPHA:1538)
- Dandy-Walker malformation (HP:0001305): A congenital brain malformation typically characterized by incomplete formation of the cerebellar vermis, dilation of the fourth ventricle, and enlargement of the posterior fossa. In layman's terms, Dandy Walker malformation is a cyst in the cerebellum (typically symmetrical) that is involved with the fourth ventricle. This may interfere with the ability to drain cerebrospinal fluid from the brain, resulting in hydrocephalus. Dandy Walker cysts are formed during early embryonic development, while the brain forms. The cyst in the cerebellum typically has several blood vessels running through it connecting to the brain, thereby prohibiting surgical removal. Evidence: TAS. Frequency: Very frequent (HP:0040281). (ORPHA:1538)
- Cerebellar hypoplasia (HP:0001321): Cerebellar hypoplasia is a descriptive term implying a cerebellum with a reduced volume, but a normal shape and is stable over time. Evidence: TAS. Frequency: Very frequent (HP:0040281). (ORPHA:1538)
- Frontal bossing (HP:0002007): Bilateral bulging of the lateral frontal bone prominences with relative sparing of the midline. Evidence: TAS. Frequency: Very frequent (HP:0040281). (ORPHA:1538)
- Orbital craniosynostosis (HP:0005472). Evidence: TAS. Frequency: Very frequent (HP:0040281). (ORPHA:1538)